- Encephalopathy (HP:0001298): Encephalopathy is a term that means brain disease, damage, or malfunction. In general, encephalopathy is manifested by an altered mental state. Evidence: PCS. Frequency: 1/1. (PMID:28449119)
- Homocystinuria (HP:0002156): An increased concentration of homocystine in the urine. Evidence: PCS. Frequency: 0/1. (PMID:28449119)
- Hypermetropia (HP:0000540): An abnormality of refraction characterized by the ability to see objects in the distance clearly, while objects nearby appear blurry. Evidence: PCS. Frequency: 1/1. (PMID:28449119)
- Abnormal circulating methionine concentration (HP:0010901): Any deviation from the normal concentration of methionine in the blood circulation. Evidence: PCS. Frequency: 0/1. (PMID:28449119)
- Profound intellectual disability (HP:0002187): Profound intellectual disability (ID) is defined as a type of ID characterized by profoundly sub-average adaptive functioning and intellectual functioning, with an intelligence quotient (IQ) below 20. Evidence: PCS. Frequency: 1/1. (PMID:28449119)
- Global developmental delay (HP:0001263): A delay in the achievement of motor or mental milestones in the domains of development of a child, including motor skills, speech and language, cognitive skills, and social and emotional skills. This term should only be used to describe children younger than five years of age. Evidence: PCS. Frequency: 1/1. (PMID:28449119)
- Infantile onset (HP:0003593): Onset of signs or symptoms of disease between 28 days to one year of life. Evidence: PCS. Frequency: 1/1. (PMID:28449119)
- Myoclonic seizure (HP:0032794): A myoclonic seizure is a type of motor seizure characterized by sudden, brief (<100 ms) involuntary single or multiple contraction of muscles or muscle groups of variable topography (axial, proximal limb, distal). Myoclonus is less regularly repetitive and less sustained than is clonus. Evidence: PCS. Frequency: 1/1. (PMID:28449119)
- Methylmalonic aciduria (HP:0012120): Increased concentration of methylmalonic acid in the urine. Evidence: PCS. Frequency: 1/1. (PMID:28449119)
- Autosomal recessive inheritance (HP:0000007): A mode of inheritance that is observed for traits related to a gene encoded on one of the autosomes (i.e., the human chromosomes 1-22) in which a trait manifests in individuals with two pathogenic alleles, either homozygotes (two copies of the same mutant allele) or compound heterozygotes (whereby each copy of a gene has a distinct mutant allele). Evidence: PCS. (PMID:28449119)
- Abnormal heart morphology (HP:0001627): Any structural anomaly of the heart. Evidence: PCS. Frequency: 0/1. (PMID:28449119)
- Esotropia (HP:0000565): A form of strabismus with one or both eyes turned inward ('crossed') to a relatively severe degree, usually defined as 10 diopters or more. Evidence: PCS. Frequency: 1/1. (PMID:28449119)
- Tetraplegia (HP:0002445): Paralysis of all four limbs, and trunk of the body below the level of an associated injury to the spinal cord. The etiology of quadriplegia is similar to that of paraplegia except that the lesion is in the cervical spinal cord rather than in the thoracic or lumbar segments of the spinal cord. Evidence: PCS. Frequency: 1/1. (PMID:28449119)
These phenotypes are associated with the disease methylmalonic aciduria and homocystinuria, cb1L type (OMIM:620940).